Phenotypes associated with the disease Tetrasomy 5p syndrome (ORPHA:3309):
- Seizure (HP:0001250): A seizure is an intermittent abnormality of nervous system physiology characterized by a transient occurrence of signs and/or symptoms due to abnormal excessive or synchronous neuronal activity in the brain. Evidence: TAS. Frequency: Very frequent (HP:0040281). (ORPHA:3309)
- Global developmental delay (HP:0001263): A delay in the achievement of motor or mental milestones in the domains of development of a child, including motor skills, speech and language, cognitive skills, and social and emotional skills. This term should only be used to describe children younger than five years of age. Evidence: TAS. Frequency: Very frequent (HP:0040281). (ORPHA:3309)
- Neonatal hypotonia (HP:0001319): Muscular hypotonia (abnormally low muscle tone) manifesting in the neonatal period. Evidence: TAS. Frequency: Very frequent (HP:0040281). (ORPHA:3309)
- Cerebellar hypoplasia (HP:0001321): Cerebellar hypoplasia is a descriptive term implying a cerebellum with a reduced volume, but a normal shape and is stable over time. Evidence: TAS. Frequency: Very frequent (HP:0040281). (ORPHA:3309)
- Congestive heart failure (HP:0001635): The presence of an abnormality of cardiac function that is responsible for the failure of the heart to pump blood at a rate that is commensurate with the needs of the tissues or a state in which abnormally elevated filling pressures are required for the heart to do so. Heart failure is frequently related to a defect in myocardial contraction. Evidence: TAS. Frequency: Very frequent (HP:0040281). (ORPHA:3309)
- Overlapping toe (HP:0001845): Describes a foot digit resting on the dorsal surface of an adjacent digit when the foot is at rest. Initially clawing may be dynamic and only noticeable on walking. Over time the plantar plate tears, subluxation occurs at the metatarsophalangeal joint (MTPJ), and the deformity becomes permanent. Evidence: TAS. Frequency: Very frequent (HP:0040281). (ORPHA:3309)
- Pulmonary arterial hypertension (HP:0002092): Pulmonary hypertension is defined mean pulmonary artery pressure of 25mmHg or more and pulmonary capillary wedge pressure of 15mmHg or less when measured by right heart catheterisation at rest and in a supine position. Evidence: TAS. Frequency: Very frequent (HP:0040281). (ORPHA:3309)
- Short nose (HP:0003196): Distance from nasion to subnasale more than two standard deviations below the mean, or alternatively, an apparently decreased length from the nasal root to the nasal tip. Evidence: TAS. Frequency: Very frequent (HP:0040281). (ORPHA:3309)
- Pericallosal lipoma (HP:0006931): Pericallosal lipomas are congenital soft masses of adipose cells encapsulated by a thin layer of fibrous tissue, appearing adjacent to the corpus callosum of the brain. Evidence: TAS. Frequency: Very frequent (HP:0040281). (ORPHA:3309)
- Midface retrusion (HP:0011800): Posterior positions and/or vertical shortening of the infraorbital and perialar regions, or increased concavity of the face and/or reduced nasolabial angle. Evidence: TAS. Frequency: Very frequent (HP:0040281). (ORPHA:3309)
- Flat face (HP:0012368): Absence of concavity or convexity of the face when viewed in profile. Evidence: TAS. Frequency: Very frequent (HP:0040281). (ORPHA:3309)
- Long fingers (HP:0100807): The middle finger is more than 2 SD above the mean for newborns 27 to 41 weeks EGA or above the 97th centile for children from birth to 16 years of age AND the five digits retain their normal length proportions relative to each other (i.e., it is not the case that the middle finger is the only lengthened digit), or, Fingers that appear disproportionately long compared to the palm of the hand. Evidence: TAS. Frequency: Very frequent (HP:0040281). (ORPHA:3309)
- Hypertelorism (HP:0000316): Interpupillary distance more than 2 SD above the mean (alternatively, the appearance of an increased interpupillary distance or widely spaced eyes). Evidence: TAS. Frequency: Frequent (HP:0040282). (ORPHA:3309)
- Long philtrum (HP:0000343): Distance between nasal base and midline upper lip vermilion border more than 2 SD above the mean. Alternatively, an apparently increased distance between nasal base and midline upper lip vermilion border. Evidence: TAS. Frequency: Frequent (HP:0040282). (ORPHA:3309)
- Low-set ears (HP:0000369): Upper insertion of the ear to the scalp below an imaginary horizontal line drawn between the inner canthi of the eye and extending posteriorly to the ear. Evidence: TAS. Frequency: Frequent (HP:0040282). (ORPHA:3309)
- Wide nasal bridge (HP:0000431): Increased breadth of the nasal bridge (and with it, the nasal root). Evidence: TAS. Frequency: Frequent (HP:0040282). (ORPHA:3309)
- Short neck (HP:0000470): Diminished length of the neck. Evidence: TAS. Frequency: Frequent (HP:0040282). (ORPHA:3309)
- Upslanted palpebral fissure (HP:0000582): The palpebral fissure inclination is more than two standard deviations above the mean for age (objective); or, the inclination of the palpebral fissure is greater than typical for age. Evidence: TAS. Frequency: Frequent (HP:0040282). (ORPHA:3309)
- Failure to thrive (HP:0001508): Failure to thrive (FTT) refers to a child whose physical growth is substantially below the norm. Evidence: TAS. Frequency: Frequent (HP:0040282). (ORPHA:3309)
- Talipes equinovarus (HP:0001762): Talipes equinovarus (also called clubfoot) typically has four main components: inversion and adduction of the forefoot; inversion of the heel and hindfoot; equinus (limitation of extension) of the ankle and subtalar joint; and internal rotation of the leg. Evidence: TAS. Frequency: Frequent (HP:0040282). (ORPHA:3309)
- Respiratory distress (HP:0002098): Respiratory distress is objectively observable as the physical or emotional consequences from the experience of dyspnea. The physical presentation of respiratory distress is generally referred to as labored breathing, while the sensation of respiratory distress is called shortness of breath or dyspnea. Evidence: TAS. Frequency: Frequent (HP:0040282). (ORPHA:3309)
- Recurrent respiratory infections (HP:0002205): An increased susceptibility to respiratory infections as manifested by a history of recurrent respiratory infections. Evidence: TAS. Frequency: Frequent (HP:0040282). (ORPHA:3309)
- Clinodactyly of the 5th finger (HP:0004209): Clinodactyly refers to a bending or curvature of the fifth finger in the radial direction (i.e., towards the 4th finger). Evidence: TAS. Frequency: Frequent (HP:0040282). (ORPHA:3309)
- Preauricular pit (HP:0004467): Small indentation anterior to the insertion of the ear. Evidence: TAS. Frequency: Frequent (HP:0040282). (ORPHA:3309)
- Redundant neck skin (HP:0005989): Excess skin around the neck, often lying in horizontal folds. Evidence: TAS. Frequency: Frequent (HP:0040282). (ORPHA:3309)
- Postnatal growth retardation (HP:0008897): Slow or limited growth after birth. Evidence: TAS. Frequency: Frequent (HP:0040282). (ORPHA:3309)
- Short hallux (HP:0010109): Underdevelopment (hypoplasia) of the big toe. Evidence: TAS. Frequency: Frequent (HP:0040282). (ORPHA:3309)
- Heart murmur (HP:0030148): An extra or unusual sound heard during a heartbeat caused vibrations resulting from the flow of blood through the heart. Evidence: TAS. Frequency: Frequent (HP:0040282). (ORPHA:3309)
- High palate (HP:0000218): Height of the palate more than 2 SD above the mean (objective) or palatal height at the level of the first permanent molar more than twice the height of the teeth (subjective). Evidence: TAS. Frequency: Occasional (HP:0040283). (ORPHA:3309)
- Wide anterior fontanel (HP:0000260): Enlargement of the anterior fontanelle with respect to age-dependent norms. Evidence: TAS. Frequency: Occasional (HP:0040283). (ORPHA:3309)
- Epicanthus (HP:0000286): A fold of skin starting above the medial aspect of the upper eyelid and arching downward to cover, pass in front of and lateral to the medial canthus. Evidence: TAS. Frequency: Occasional (HP:0040283). (ORPHA:3309)
- Weak cry (HP:0001612). Evidence: TAS. Frequency: Occasional (HP:0040283). (ORPHA:3309)
- Pulmonary hypoplasia (HP:0002089). Evidence: TAS. Frequency: Occasional (HP:0040283). (ORPHA:3309)
- Depigmentation/hyperpigmentation of skin (HP:0007483). Evidence: TAS. Frequency: Occasional (HP:0040283). (ORPHA:3309)
- Aplasia/Hypoplasia of the abdominal wall musculature (HP:0010318): Absence or underdevelopment of the abdominal musculature. Evidence: TAS. Frequency: Occasional (HP:0040283). (ORPHA:3309)
- Hydrocephalus (HP:0000238): Hydrocephalus is an active distension of the ventricular system of the brain resulting from inadequate passage of CSF from its point of production within the cerebral ventricles to its point of absorption into the systemic circulation. Evidence: TAS. Frequency: Very frequent (HP:0040281). (ORPHA:3309)
- Macrocephaly (HP:0000256): Occipitofrontal (head) circumference greater than 97th centile compared to appropriate, age matched, sex-matched normal standards. Alternatively, a apparently increased size of the cranium. Evidence: TAS. Frequency: Very frequent (HP:0040281). (ORPHA:3309)
- Coarse facial features (HP:0000280): Absence of fine and sharp appearance of brows, nose, lips, mouth, and chin, usually because of rounded and heavy features or thickened skin with or without thickening of subcutaneous and bony tissues. Evidence: TAS. Frequency: Very frequent (HP:0040281). (ORPHA:3309)
- Full cheeks (HP:0000293): Increased prominence or roundness of soft tissues between zygomata and mandible. Evidence: TAS. Frequency: Very frequent (HP:0040281). (ORPHA:3309)
- Micrognathia (HP:0000347): Developmental hypoplasia of the mandible. Evidence: TAS. Frequency: Very frequent (HP:0040281). (ORPHA:3309)
- Posteriorly rotated ears (HP:0000358): A type of abnormal location of the ears in which the position of the ears is characterized by posterior rotation (the superior part of the ears is rotated towards the back of the head, and the inferior part of the ears towards the front). Evidence: TAS. Frequency: Very frequent (HP:0040281). (ORPHA:3309)
- Anteverted nares (HP:0000463): Anteriorly-facing nostrils viewed with the head in the Frankfurt horizontal and the eyes of the observer level with the eyes of the subject. This gives the appearance of an upturned nose (upturned nasal tip). Evidence: TAS. Frequency: Very frequent (HP:0040281). (ORPHA:3309)
- Pectus excavatum (HP:0000767): A defect of the chest wall characterized by a depression of the sternum, giving the chest ("pectus") a caved-in ("excavatum") appearance. Evidence: TAS. Frequency: Very frequent (HP:0040281). (ORPHA:3309)
- Cyanosis (HP:0000961): Bluish discoloration of the skin and mucosa due to poor circulation or inadequate oxygenation of arterial or capillary blood. Evidence: TAS. Frequency: Very frequent (HP:0040281). (ORPHA:3309)